Phenotypes associated with the disease Febrile infection-related epilepsy syndrome (ORPHA:163703):
- Sinusitis (HP:0000246): Inflammation of the paranasal sinuses owing to a viral, bacterial, or fungal infection, allergy, or an autoimmune reaction. Evidence: TAS. Frequency: Frequent (HP:0040282). (ORPHA:163703)
- Atypical behavior (HP:0000708): Atypical behavior is an abnormality in a person's actions that can be controlled or modulated by the will of the individual. While abnormal behaviors can be difficult to control, they are distinct from other abnormal actions that cannot be affected by the individual's will. Evidence: TAS. Frequency: Frequent (HP:0040282). (ORPHA:163703)
- Lethargy (HP:0001254): A state of fatigue, either physical or mental slowness and sluggishness, with difficulties in initiating or performing simple tasks. Distinguished from apathy which implies indifference and a lack of desire or interest in the task. A person with lethargy may have the desire, but not the energy to engage in personal or socially relevant tasks. Evidence: TAS. Frequency: Very frequent (HP:0040281). (ORPHA:163703)
- Sudden death (HP:0001699): Rapid and unexpected death. Evidence: TAS. Frequency: Occasional (HP:0040283). (ORPHA:163703)
- Fever (HP:0001945): Body temperature elevated above the normal range. Evidence: TAS. Frequency: Frequent (HP:0040282). (ORPHA:163703)
- Headache (HP:0002315): Cephalgia, or pain sensed in various parts of the head, not confined to the area of distribution of any nerve. Evidence: TAS. Frequency: Frequent (HP:0040282). (ORPHA:163703)
- EEG abnormality (HP:0002353): Abnormality observed by electroencephalogram (EEG), which is used to record of the brain's spontaneous electrical activity from multiple electrodes placed on the scalp. Evidence: TAS. Frequency: Very frequent (HP:0040281). (ORPHA:163703)
- Developmental regression (HP:0002376): Loss of developmental skills, as manifested by loss of developmental milestones. Evidence: TAS. Frequency: Very frequent (HP:0040281). (ORPHA:163703)
- Autoimmunity (HP:0002960): The occurrence of an immune reaction against the organism's own cells or tissues. Evidence: TAS. Frequency: Occasional (HP:0040283). (ORPHA:163703)
- Myalgia (HP:0003326): Pain in muscle. Evidence: TAS. Frequency: Frequent (HP:0040282). (ORPHA:163703)
- Focal-onset seizure (HP:0007359): A focal-onset seizure is a type of seizure originating within networks limited to one hemisphere. They may be discretely localized or more widely distributed, and may originate in subcortical structures. Evidence: TAS. Frequency: Very frequent (HP:0040281). (ORPHA:163703)
- Cough (HP:0012735): A sudden, audible expulsion of air from the lungs through a partially closed glottis, preceded by inhalation. Evidence: TAS. Frequency: Frequent (HP:0040282). (ORPHA:163703)